Phenotypes associated with the disease familial multiple nevi flammei (OMIM:163000, an entry in Online Mendelian Inheritance in Man):
- Nevus flammeus (HP:0001052, a Human Phenotype Ontology term): A congenital vascular malformation consisting of superficial and deep dilated capillaries in the skin which produce a reddish to purplish discolouration of the skin. Evidence: IEA. (OMIM:163000)
- Autosomal dominant inheritance (HP:0000006, a Human Phenotype Ontology term): A mode of inheritance that is observed for traits related to a gene encoded on one of the autosomes (i.e., the human chromosomes 1-22) in which a trait manifests in heterozygotes. In the context of medical genetics, an autosomal dominant disorder is caused when a single copy of the mutant allele is present. Males and females are affected equally, and can both transmit the disorder with a risk of 50% for each child of inheriting the mutant allele. Evidence: IEA. (OMIM:163000)